Phenotypes associated with the disease mediosternal depigmentation line (OMIM:155200):
- Mediosternal, longitudinal streak of hypopigmentation (HP:0007581). Evidence: IEA. (OMIM:155200)
- Autosomal dominant inheritance (HP:0000006): A mode of inheritance that is observed for traits related to a gene encoded on one of the autosomes (i.e., the human chromosomes 1-22) in which a trait manifests in heterozygotes. In the context of medical genetics, an autosomal dominant disorder is caused when a single copy of the mutant allele is present. Males and females are affected equally, and can both transmit the disorder with a risk of 50% for each child of inheriting the mutant allele. Evidence: IEA. (OMIM:155200)